- Hyperinsulinemia (HP:0000842): An increased concentration of insulin in the blood. Evidence: TAS. Frequency: Very frequent (HP:0040281). (ORPHA:2298)
- Insulin resistance (HP:0000855): Increased resistance towards insulin, that is, diminished effectiveness of insulin in reducing blood glucose levels. Evidence: TAS. Frequency: Very frequent (HP:0040281). (ORPHA:2298)
- Acanthosis nigricans (HP:0000956): A dermatosis characterized by thickened, hyperpigmented plaques, typically on the intertriginous surfaces and neck. Evidence: TAS. Frequency: Very frequent (HP:0040281). (ORPHA:2298)
- Weight loss (HP:0001824): Reduction of total body weight. Evidence: TAS. Frequency: Very frequent (HP:0040281). (ORPHA:2298)
- Glucose intolerance (HP:0001952): Glucose intolerance (GI) can be defined as dysglycemia that comprises both prediabetes and diabetes. It includes the conditions of impaired fasting glucose (IFG) and impaired glucose tolerance (IGT) and diabetes mellitus (DM). Evidence: TAS. Frequency: Very frequent (HP:0040281). (ORPHA:2298)
- Systemic lupus erythematosus (HP:0002725): A chronic, relapsing, inflammatory, and often febrile multisystemic disorder of connective tissue, characterized principally by involvement of the skin, joints, kidneys, and serosal membranes. Evidence: TAS. Frequency: Very frequent (HP:0040281). (ORPHA:2298)
- Autoimmunity (HP:0002960): The occurrence of an immune reaction against the organism's own cells or tissues. Evidence: TAS. Frequency: Very frequent (HP:0040281). (ORPHA:2298)
- Hyperglycemia (HP:0003074): An increased concentration of glucose in the blood. Evidence: TAS. Frequency: Very frequent (HP:0040281). (ORPHA:2298)
- Elevated erythrocyte sedimentation rate (HP:0003565): An increased erythrocyte sedimentation rate (ESR). The ESR is a test that measures the distance that erythrocytes have fallen after one hour in a vertical column of anticoagulated blood under the influence of gravity. The ESR is a nonspecific finding. An elevation may indicate inflammation or may be caused by any condition that elevates fibrinogen. Evidence: TAS. Frequency: Very frequent (HP:0040281). (ORPHA:2298)
- Abnormal circulating fatty acid concentration (HP:0004359): Any deviation from the normal concentration of fatty acid in the blood circulation. Evidence: TAS. Frequency: Very frequent (HP:0040281). (ORPHA:2298)
- Abnormal oral glucose tolerance (HP:0004924): An abnormal resistance to glucose, i.e., a reduction in the ability to maintain glucose levels in the blood stream within normal limits following oral administration of glucose. Evidence: TAS. Frequency: Very frequent (HP:0040281). (ORPHA:2298)
- Fasting hyperinsulinemia (HP:0008283): An increased concentration of insulin in the blood in the fasting state, i.e., not as the response to food intake. Evidence: TAS. Frequency: Very frequent (HP:0040281). (ORPHA:2298)
- Postprandial hyperglycemia (HP:0011998): An increased concentration of glucose in the blood following a meal. Evidence: TAS. Frequency: Very frequent (HP:0040281). (ORPHA:2298)
- Hypotriglyceridemia (HP:0012153): An decrease in the level of triglycerides in the blood. Evidence: TAS. Frequency: Very frequent (HP:0040281). (ORPHA:2298)
- Proteinuria (HP:0000093): Increased levels of protein in the urine. Evidence: TAS. Frequency: Frequent (HP:0040282). (ORPHA:2298)
- Nephritis (HP:0000123): The presence of inflammation affecting the kidney. Evidence: TAS. Frequency: Frequent (HP:0040282). (ORPHA:2298)
- Polycystic ovaries (HP:0000147). Evidence: TAS. Frequency: Frequent (HP:0040282). (ORPHA:2298)
- Insulin-resistant diabetes mellitus (HP:0000831): A type of diabetes mellitus related not to lack of insulin but rather to lack of response to insulin on the part of the target tissues of insulin such as muscle, fat, and liver cells. This type of diabetes is typically associated with increases both in blood glucose concentrations as well as in fasting and postprandial serum insulin levels. Evidence: TAS. Frequency: Frequent (HP:0040282). (ORPHA:2298)
- Hirsutism (HP:0001007): Abnormally increased hair growth referring to a male pattern of body hair (androgenic hair). Evidence: TAS. Frequency: Frequent (HP:0040282). (ORPHA:2298)
- Decreased total leukocyte count (HP:0001882): An abnormal decreased number of leukocytes in the blood. Evidence: TAS. Frequency: Frequent (HP:0040282). (ORPHA:2298)
- Hypoalbuminemia (HP:0003073): The concentration of albumin in the blood circulation is below the lower limit of normal. Evidence: TAS. Frequency: Frequent (HP:0040282). (ORPHA:2298)
- Glycosuria (HP:0003076): An increased concentration of glucose in the urine. Evidence: TAS. Frequency: Frequent (HP:0040282). (ORPHA:2298)
- Abnormal circulating lipid concentration (HP:0003119): Any deviation from the normal concentration of a lipid in the blood circulation. Evidence: TAS. Frequency: Frequent (HP:0040282). (ORPHA:2298)
- Antinuclear antibody positivity (HP:0003493): The presence of autoantibodies in the serum that react against nuclei or nuclear components. Evidence: TAS. Frequency: Frequent (HP:0040282). (ORPHA:2298)
- Abnormality of body weight (HP:0004323): An abnormal increase or decrease of weight or an abnormal distribution of mass in the body. Evidence: TAS. Frequency: Frequent (HP:0040282). (ORPHA:2298)
- Decreased body weight (HP:0004325): Abnormally low body weight. Evidence: TAS. Frequency: Frequent (HP:0040282). (ORPHA:2298)
- Abnormal circulating leptin concentration (HP:0004361): An abnormal concentration of leptin in the blood. Evidence: TAS. Frequency: Frequent (HP:0040282). (ORPHA:2298)
- Decreased circulating complement factor B concentration (HP:0005416): Concentration of the complement component factor B in the blood circulation below the lower limit of normal. Evidence: TAS. Frequency: Frequent (HP:0040282). (ORPHA:2298)
- Type II diabetes mellitus (HP:0005978): A type of diabetes mellitus initially characterized by insulin resistance and hyperinsulinemia and subsequently by glucose interolerance and hyperglycemia. Evidence: TAS. Frequency: Frequent (HP:0040282). (ORPHA:2298)
- Enlarged polycystic ovaries (HP:0008675). Evidence: TAS. Frequency: Frequent (HP:0040282). (ORPHA:2298)
- Fatigue (HP:0012378): A subjective feeling of tiredness characterized by a lack of energy and motivation. Evidence: TAS. Frequency: Frequent (HP:0040282). (ORPHA:2298)
- Increased serum testosterone level (HP:0030088): An elevated circulating testosterone level in the blood. Evidence: TAS. Frequency: Frequent (HP:0040282). (ORPHA:2298)
- Enlarged ovaries (HP:0100879). Evidence: TAS. Frequency: Frequent (HP:0040282). (ORPHA:2298)
- Hyperinsulinemic hypoglycemia (HP:0000825): An increased concentration of insulin combined with a decreased concentration of glucose in the blood. Evidence: TAS. Frequency: Occasional (HP:0040283). (ORPHA:2298)
- Skin rash (HP:0000988): A red eruption of the skin. Evidence: TAS. Frequency: Occasional (HP:0040283). (ORPHA:2298)
- Alopecia (HP:0001596): A noncongenital process of hair loss, which may progress to partial or complete baldness. Evidence: TAS. Frequency: Occasional (HP:0040283). (ORPHA:2298)
- Thrombocytopenia (HP:0001873): A reduction in the number of circulating thrombocytes. Evidence: TAS. Frequency: Occasional (HP:0040283). (ORPHA:2298)
- Ketosis (HP:0001946): Presence of elevated levels of ketone bodies in the body. Evidence: TAS. Frequency: Occasional (HP:0040283). (ORPHA:2298)
- Diabetic ketoacidosis (HP:0001953): A type of diabetic metabolic abnormality with an accumulation of ketone bodies. Evidence: TAS. Frequency: Occasional (HP:0040283). (ORPHA:2298)
- Pneumonia (HP:0002090): Inflammation of any part of the lung parenchyma. Evidence: TAS. Frequency: Occasional (HP:0040283). (ORPHA:2298)
- Biliary cirrhosis (HP:0002613): Progressive destruction of the small-to-medium bile ducts of the intrahepatic biliary tree, which leads to progressive cholestasis and often end-stage liver disease. Evidence: TAS. Frequency: Occasional (HP:0040283). (ORPHA:2298)
- Lymphoma (HP:0002665): A cancer originating in lymphocytes and presenting as a solid tumor of lymhpoid cells. Evidence: TAS. Frequency: Occasional (HP:0040283). (ORPHA:2298)
- Osteoarthritis (HP:0002758): Degeneration (wear and tear) of articular cartilage, i.e., of the joint surface. Joint degeneration may be accompanied by osteophytes (bone overgrowth), narrowing of the joint space, regions of sclerosis at the joint surface, or joint deformity. Evidence: TAS. Frequency: Occasional (HP:0040283). (ORPHA:2298)
- Fasting hypoglycemia (HP:0003162). Evidence: TAS. Frequency: Occasional (HP:0040283). (ORPHA:2298)
- Increased circulating IgG concentration (HP:0003237): An abnormally increased level of immunoglobulin G in blood. Evidence: TAS. Frequency: Occasional (HP:0040283). (ORPHA:2298)
- Increased circulating IgA concentration (HP:0003261): An abnormally increased level of immunoglobulin A in blood. Evidence: TAS. Frequency: Occasional (HP:0040283). (ORPHA:2298)
- Increased body weight (HP:0004324): Abnormally increased body weight. Evidence: TAS. Frequency: Occasional (HP:0040283). (ORPHA:2298)
- Multiple myeloma (HP:0006775): A malignant plasma cell tumor growing within soft tissue or within the skeleton. Evidence: TAS. Frequency: Occasional (HP:0040283). (ORPHA:2298)
- Abnormal salivary gland morphology (HP:0010286): Any abnormality of the salivary glands, the exocrine glands that produce saliva. Evidence: TAS. Frequency: Occasional (HP:0040283). (ORPHA:2298)
- Hodgkin lymphoma (HP:0012189): A type of lymphoma characterized microscopically by multinucleated Reed-Sternberg cells. Evidence: TAS. Frequency: Occasional (HP:0040283). (ORPHA:2298)
These phenotypes are associated with the disease Insulin-resistance syndrome type B (ORPHA:2298).